Phenotypes associated with the disease chromosome 5p13 duplication syndrome (OMIM:613174):
- Epicanthus (HP:0000286): A fold of skin starting above the medial aspect of the upper eyelid and arching downward to cover, pass in front of and lateral to the medial canthus. Evidence: PCS. Frequency: 1/6. (PMID:19052029)
- Narrow forehead (HP:0000341): Width of the forehead or distance between the frontotemporales is more than two standard deviations below the mean (objective); or apparently narrow intertemporal region (subjective). Evidence: PCS. Frequency: 2/6. (PMID:19052029)
- Astigmatism (HP:0000483): A type of refraction error associated with abnormal curvatures on the anterior and/or posterior surface of the cornea. Evidence: PCS. Frequency: 1/6. (PMID:19052029)
- Large hands (HP:0001176). Evidence: PCS. Frequency: 1/6. (PMID:19052029)
- Upslanted palpebral fissure (HP:0000582): The palpebral fissure inclination is more than two standard deviations above the mean for age (objective); or, the inclination of the palpebral fissure is greater than typical for age. Evidence: PCS. Frequency: 1/6. (PMID:19052029)
- Strabismus (HP:0000486): A misalignment of the eyes so that the visual axes deviate from bifoveal fixation. The classification of strabismus may be based on a number of features including the relative position of the eyes, whether the deviation is latent or manifest, intermittent or constant, concomitant or otherwise and according to the age of onset and the relevance of any associated refractive error. Evidence: PCS. Frequency: 1/6. (PMID:19052029)
- Seizure (HP:0001250): A seizure is an intermittent abnormality of nervous system physiology characterized by a transient occurrence of signs and/or symptoms due to abnormal excessive or synchronous neuronal activity in the brain. Evidence: PCS. Frequency: 2/5. (PMID:19052029)
- Agenesis of corpus callosum (HP:0001274): Absence of the corpus callosum as a result of the failure of the corpus callosum to develop, which can be the result of a failure in any one of the multiple steps of callosal development including cellular proliferation and migration, axonal growth or glial patterning at the midline. Evidence: PCS. Frequency: 1/6. (PMID:19052029)
- Blepharophimosis (HP:0000581): A fixed reduction in the vertical distance between the upper and lower eyelids with short palpebral fissures. Evidence: IEA. (OMIM:613174)
- Hypotonia (HP:0001252): Hypotonia is an abnormally low muscle tone (the amount of tension or resistance to movement in a muscle). Even when relaxed, muscles have a continuous and passive partial contraction which provides some resistance to passive stretching. Hypotonia thus manifests as diminished resistance to passive stretching. Hypotonia is not the same as muscle weakness, although the two conditions can co-exist. Evidence: PCS. Frequency: 3/5. (PMID:19052029)
- Low posterior hairline (HP:0002162): Hair on the neck extends more inferiorly than usual. Evidence: PCS. Frequency: 1/6. (PMID:19052029)
- Sleep disturbance (HP:0002360): An abnormal pattern in the quality, quantity, or characteristics of sleep. Evidence: PCS. Frequency: 3/5. (PMID:19052029)
- Turricephaly (HP:0000262): Tall head relative to width and length. Evidence: PCS. Frequency: 1/6. (PMID:19052029)
- Short palpebral fissure (HP:0012745): Distance between the medial and lateral canthi is more than 2 SD below the mean for age (objective); or, apparently reduced length of the palpebral fissures. Evidence: PCS. Frequency: 2/6. (PMID:19052029)
- Sparse hair (HP:0008070): Reduced density of hairs. Evidence: PCS. Frequency: 1/6. (PMID:19052029)
- Hypertelorism (HP:0000316): Interpupillary distance more than 2 SD above the mean (alternatively, the appearance of an increased interpupillary distance or widely spaced eyes). Evidence: PCS. Frequency: 1/6. (PMID:19052029)
- Single transverse palmar crease (HP:0000954): The distal and proximal transverse palmar creases are merged into a single transverse palmar crease. Evidence: PCS. Frequency: 2/6. (PMID:19052029)
- Broad forehead (HP:0000337): Width of the forehead or distance between the frontotemporales is more than two standard deviations above the mean (objective); or apparently increased distance between the two sides of the forehead. Evidence: PCS. Frequency: 1/6. (PMID:19052029)
- Bulbous nose (HP:0000414): Increased volume and globular shape of the anteroinferior aspect of the nose. Evidence: PCS. Frequency: 1/6. (PMID:19052029)
- Long fingers (HP:0100807): The middle finger is more than 2 SD above the mean for newborns 27 to 41 weeks EGA or above the 97th centile for children from birth to 16 years of age AND the five digits retain their normal length proportions relative to each other (i.e., it is not the case that the middle finger is the only lengthened digit), or, Fingers that appear disproportionately long compared to the palm of the hand. Evidence: PCS. Frequency: 3/6. (PMID:19052029)
- Motor stereotypy (HP:0000733): Use of the same abnormal action in response to certain triggers or at random. They may be used as a way to regulate one's internal state but must otherwise have no apparent functional purpose. Evidence: PCS. Frequency: 1/6. (PMID:19052029)
- Long palpebral fissure (HP:0000637): Distance between medial and lateral canthi is more than two standard deviations above the mean for age (objective); or, apparently increased length of the palpebral fissures. Evidence: PCS. Frequency: 1/6. (PMID:19052029)
- Downturned corners of mouth (HP:0002714): A morphological abnormality of the mouth in which the angle of the mouth is downturned. The oral commissures are positioned inferior to the midline labial fissure. Evidence: PCS. Frequency: 1/6. (PMID:19052029)
- High palate (HP:0000218): Height of the palate more than 2 SD above the mean (objective) or palatal height at the level of the first permanent molar more than twice the height of the teeth (subjective). Evidence: PCS. Frequency: 3/6. (PMID:19052029)
- Low hanging columella (HP:0009765): Columella extending inferior to the level of the nasal base, when viewed from the side. Evidence: PCS. Frequency: 1/6. (PMID:19052029)
- Sporadic (HP:0003745): Cases of the disease in question occur without a previous family history, i.e., as isolated cases without being transmitted from a parent and without other siblings being affected. Evidence: IEA. (OMIM:613174)
- Macrocephaly (HP:0000256): Occipitofrontal (head) circumference greater than 97th centile compared to appropriate, age matched, sex-matched normal standards. Alternatively, a apparently increased size of the cranium. Evidence: PCS. Frequency: 1/6. (PMID:19052029)
- Intellectual disability (HP:0001249): The term intellectual disability or intellectual developmental disorder is used to describe significantly sub-average intellectual and adaptive functioning based on clinical assessment and as measured by individually administered, appropriately normed, standardized and validated tests of intellectual functioning and adaptive behavior, with onset during the developmental period from infancy through adolescence. Evidence: PCS. Frequency: 5/5. (PMID:19052029)
- Posteriorly rotated ears (HP:0000358): A type of abnormal location of the ears in which the position of the ears is characterized by posterior rotation (the superior part of the ears is rotated towards the back of the head, and the inferior part of the ears towards the front). Evidence: PCS. Frequency: 1/6. (PMID:19052029)
- Exotropia (HP:0000577): A form of strabismus with one or both eyes deviated outward. Evidence: PCS. Frequency: 1/6. (PMID:19052029)
- Craniosynostosis (HP:0001363): Craniosynostosis refers to the premature closure of the cranial sutures. Primary craniosynostosis refers to the closure of one or more sutures due to abnormalities in skull development, and secondary craniosynostosis results from failure of brain growth. Evidence: PCS. Frequency: 1/6. (PMID:19052029)
- Vesicoureteral reflux (HP:0000076): Abnormal (retrograde) movement of urine from the bladder into ureters or kidneys related to inadequacy of the valvular mechanism at the ureterovesicular junction or other causes. Evidence: PCS. Frequency: 1/6. (PMID:19052029)
- Scoliosis (HP:0002650): The presence of an abnormal lateral curvature of the spine. Evidence: PCS. Frequency: 1/6. (PMID:19052029)
- Wide nasal bridge (HP:0000431): Increased breadth of the nasal bridge (and with it, the nasal root). Evidence: PCS. Frequency: 2/6. (PMID:19052029)
- Global developmental delay (HP:0001263): A delay in the achievement of motor or mental milestones in the domains of development of a child, including motor skills, speech and language, cognitive skills, and social and emotional skills. This term should only be used to describe children younger than five years of age. Evidence: PCS. Frequency: 6/6. (PMID:19052029)
- Small for gestational age (HP:0001518): Smaller than normal size according to sex and gestational age related norms, defined as a weight below the 10th percentile for the gestational age. Evidence: PCS. (PMID:19052029)
- Hypotelorism (HP:0000601): Interpupillary distance less than 2 SD below the mean (alternatively, the appearance of an decreased interpupillary distance or closely spaced eyes). Evidence: PCS. Frequency: 1/6. (PMID:19052029)
- Long foot (HP:0001833): Increased back to front length of the foot. Evidence: PCS. Frequency: 1/6. (PMID:19052029)
- Compulsive behaviors (HP:0000722): Behavior that consists of repetitive acts, characterized by the feeling that one "has to" perform them, while being aware that these acts are not in line with one's overall goal. Evidence: PCS. Frequency: 1/6. (PMID:19052029)
- Self-injurious behavior (HP:0100716): Self-aggression. Evidence: PCS. Frequency: 1/5. (PMID:19052029)
- Esotropia (HP:0000565): A form of strabismus with one or both eyes turned inward ('crossed') to a relatively severe degree, usually defined as 10 diopters or more. Evidence: PCS. Frequency: 1/6. (PMID:19052029)
- Frontal bossing (HP:0002007): Bilateral bulging of the lateral frontal bone prominences with relative sparing of the midline. Evidence: PCS. Frequency: 2/6. (PMID:19052029)
- Proptosis (HP:0000520): An eye that is protruding anterior to the plane of the face to a greater extent than is typical. Evidence: PCS. Frequency: 1/6. (PMID:19052029)
- Short philtrum (HP:0000322): Distance between nasal base and midline upper lip vermilion border more than 2 SD below the mean. Alternatively, an apparently decreased distance between nasal base and midline upper lip vermilion border. Evidence: PCS. Frequency: 3/6. (PMID:19052029)
- Brachycephaly (HP:0000248): An abnormality of skull shape characterized by a decreased anterior-posterior diameter. That is, a cephalic index greater than 81%. Alternatively, an apparently shortened anteroposterior dimension (length) of the head compared to width. Evidence: PCS. Frequency: 1/6. (PMID:19052029)
- Low-set ears (HP:0000369): Upper insertion of the ear to the scalp below an imaginary horizontal line drawn between the inner canthi of the eye and extending posteriorly to the ear. Evidence: PCS. Frequency: 3/6. (PMID:19052029)